Phenotypes associated with the disease schizophrenia 17 (OMIM:621407):
- Schizophrenia (HP:0100753): A mental disorder characterized by a disintegration of thought processes and emotional responsiveness. It most commonly manifests as auditory hallucinations, paranoid or bizarre delusions, or disorganized speech and thinking. It is accompanied by significant social or occupational dysfunction. The onset of symptoms typically occurs in young adulthood, with a global lifetime prevalence of about 1%. This term is not a helpful parent term to describe abnormal experiences. Evidence: PCS. Frequency: 1/1. (PMID:21424692)
- Global developmental delay (HP:0001263): A delay in the achievement of motor or mental milestones in the domains of development of a child, including motor skills, speech and language, cognitive skills, and social and emotional skills. This term should only be used to describe children younger than five years of age. Evidence: PCS. Frequency: 0/1. (PMID:21424692)
- Sporadic (HP:0003745): Cases of the disease in question occur without a previous family history, i.e., as isolated cases without being transmitted from a parent and without other siblings being affected. Evidence: PCS. (PMID:21424692)